- Respiratory distress (HP:0002098): Respiratory distress is objectively observable as the physical or emotional consequences from the experience of dyspnea. The physical presentation of respiratory distress is generally referred to as labored breathing, while the sensation of respiratory distress is called shortness of breath or dyspnea. Evidence: TAS. Frequency: Frequent (HP:0040282). (ORPHA:70588)
- Transient pulmonary infiltrates (HP:0005828). Evidence: TAS. Frequency: Frequent (HP:0040282). (ORPHA:70588)
- Caesarean section (HP:0011410): Delivery of a fetus through surgical incisions made through the abdominal wall (laparotomy) and the uterine wall (hysterotomy). Evidence: TAS. Frequency: Frequent (HP:0040282). (ORPHA:70588)
- Fetal distress (HP:0025116): An intrauterine state characterized by suboptimal values in the fetal heart rate, oxygenation of fetal blood, or other parameters indicative of compromise of the fetus. Signs of fetal distress include repetitive variable decelerations, fetal tachycardia or bradycardia, late decelerations, or low biophysical profile. Evidence: TAS. Frequency: Frequent (HP:0040282). (ORPHA:70588)
- Postterm pregnancy (HP:0031169): A pregnancy that extends to 42 weeks of gestation or beyond. Evidence: TAS. Frequency: Frequent (HP:0040282). (ORPHA:70588)
- Abnormal heart rate variability (HP:0031860): Any abnormality in the variability of the time interval between successive heartbeats. Evidence: TAS. Frequency: Frequent (HP:0040282). (ORPHA:70588)
- Abnormal pulmonary thoracic imaging finding (HP:0031983): This term groups terms representing abnormal findings derived from chest X-ray investigation of the lung. In general, lung abnormalities can manifest as opacities (areas of increased density) or as regions with decreased density. Evidence: TAS. Frequency: Frequent (HP:0040282). (ORPHA:70588)
- Intrauterine growth retardation (HP:0001511): An abnormal restriction of fetal growth with fetal weight below the tenth percentile for gestational age. Evidence: TAS. Frequency: Occasional (HP:0040283). (ORPHA:70588)
- Premature rupture of membranes (HP:0001788): Premature rupture of membranes (PROM) is a condition which occurs in pregnancy when the amniotic sac ruptures more than an hour before the onset of labor. Evidence: TAS. Frequency: Occasional (HP:0040283). (ORPHA:70588)
- Pulmonary arterial hypertension (HP:0002092): Pulmonary hypertension is defined mean pulmonary artery pressure of 25mmHg or more and pulmonary capillary wedge pressure of 15mmHg or less when measured by right heart catheterisation at rest and in a supine position. Evidence: TAS. Frequency: Occasional (HP:0040283). (ORPHA:70588)
- Pneumothorax (HP:0002107): Accumulation of air in the pleural cavity leading to a partially or completely collapsed lung. Evidence: TAS. Frequency: Occasional (HP:0040283). (ORPHA:70588)
- Maternal hypertension (HP:0008071): Increased blood pressure during a pregnancy. Evidence: TAS. Frequency: Occasional (HP:0040283). (ORPHA:70588)
- Maternal diabetes (HP:0009800): Maternal diabetes can either be a gestational, mostly type 2 diabetes, or a type 1 diabetes. Essential is the resulting maternal hyperglycemia as a non-specific teratogen, imposing the same risk of congenital malformations to pregnant women with both type 1 and type2 diabetes. Evidence: TAS. Frequency: Occasional (HP:0040283). (ORPHA:70588)
- Aspiration pneumonia (HP:0011951): Pneumonia due to the aspiration (breathing in) of food, liquid, or gastric contents into the upper respiratory tract. Evidence: TAS. Frequency: Occasional (HP:0040283). (ORPHA:70588)
- Hypoxemia (HP:0012418): An abnormally low level of blood oxygen. Evidence: TAS. Frequency: Occasional (HP:0040283). (ORPHA:70588)
- Meconium stained amniotic fluid (HP:0012420): Amniotic fluid containing the earliest stools of a mammalian infant. Evidence: TAS. Frequency: Occasional (HP:0040283). (ORPHA:70588)
- Neonatal asphyxia (HP:0012768): Respiratory failure in the newborn. Evidence: TAS. Frequency: Occasional (HP:0040283). (ORPHA:70588)
- Pneumomediastinum (HP:0025421): The presence of free air in the mediastinum. Evidence: TAS. Frequency: Occasional (HP:0040283). (ORPHA:70588)
- Wheezing (HP:0030828): A high-pitched whistling sound associated with labored breathing. Evidence: TAS. Frequency: Occasional (HP:0040283). (ORPHA:70588)
- Atelectasis (HP:0100750): Collapse of part of a lung associated with absence of inflation (air) of that part. Evidence: TAS. Frequency: Occasional (HP:0040283). (ORPHA:70588)
- Encephalopathy (HP:0001298): Encephalopathy is a term that means brain disease, damage, or malfunction. In general, encephalopathy is manifested by an altered mental state. Evidence: TAS. Frequency: Very rare (HP:0040284). (ORPHA:70588)
- Pulmonic regurgitation (HP:0010444): The retrograde (backwards) flow of blood through the pulmonary valve into the right ventricle during diastole. Evidence: TAS. Frequency: Very rare (HP:0040284). (ORPHA:70588)
These phenotypes are associated with the disease Meconium aspiration syndrome (ORPHA:70588).